- Abnormality of metabolism/homeostasis (HP:0001939). Evidence: IEA. (OMIM:252250)
- Recurrent mucocutaneous candidiasis (HP:0002728): Recurrent or persistent superficial Candida infections of the skin, mucous membranes, and nails. Evidence: IEA. (OMIM:252250)
- Autosomal recessive inheritance (HP:0000007): A mode of inheritance that is observed for traits related to a gene encoded on one of the autosomes (i.e., the human chromosomes 1-22) in which a trait manifests in individuals with two pathogenic alleles, either homozygotes (two copies of the same mutant allele) or compound heterozygotes (whereby each copy of a gene has a distinct mutant allele). Evidence: IEA. (OMIM:252250)
- Cutaneous anergy (HP:0002965): Inability to react to a delayed hypersensitivity skin test. Evidence: IEA. (OMIM:252250)
These phenotypes are associated with the disease chronic mucocutaneous candidiasis due to monocyte chemotactic disorder (OMIM:252250).